Phenotypes associated with the disease hematuria, benign familial, 1 (OMIM:141200):
- Hematuria (HP:0000790): The presence of blood in the urine. Hematuria may be gross hematuria (visible to the naked eye) or microscopic hematuria (detected by dipstick or microscopic examination of the urine). Evidence: IEA. (OMIM:141200)
- Nonprogressive (HP:0003680): Applies to a disease manifestation that does not increase in scope or severity over the course of time, i.e., that does not worsen with age. Evidence: TAS. (OMIM:141200)
- Thin glomerular basement membrane (HP:0012577): Decreased thickness of the glomerular basement membrane (GBM), measured from endothelial to visceral epithelial plasma membrane and mainly attributable to a decrease in thickness of the lamina densa, generally to an overall thickness more than 2 standard deviations less than that of the normal mean GBM thickness for health age- and sex matched individuals. May be focal or diffuse, although the term thin GBMs generally implies thinning of over 50% of GBMs. Evidence: TAS. (OMIM:141200)
- Autosomal dominant inheritance (HP:0000006): A mode of inheritance that is observed for traits related to a gene encoded on one of the autosomes (i.e., the human chromosomes 1-22) in which a trait manifests in heterozygotes. In the context of medical genetics, an autosomal dominant disorder is caused when a single copy of the mutant allele is present. Males and females are affected equally, and can both transmit the disorder with a risk of 50% for each child of inheriting the mutant allele. Evidence: IEA. (OMIM:141200)